- High myopia (HP:0011003): A severe form of myopia with greater than -6.00 diopters. Evidence: TAS. (OMIM:613969)
- Autosomal dominant inheritance (HP:0000006): A mode of inheritance that is observed for traits related to a gene encoded on one of the autosomes (i.e., the human chromosomes 1-22) in which a trait manifests in heterozygotes. In the context of medical genetics, an autosomal dominant disorder is caused when a single copy of the mutant allele is present. Males and females are affected equally, and can both transmit the disorder with a risk of 50% for each child of inheriting the mutant allele. Evidence: TAS. (OMIM:613969)
These phenotypes are associated with the disease myopia 19, autosomal dominant (OMIM:613969).